Phenotypes associated with the disease Proximal 16p11.2 microdeletion syndrome (ORPHA:261197):
- Atypical behavior (HP:0000708): Atypical behavior is an abnormality in a person's actions that can be controlled or modulated by the will of the individual. While abnormal behaviors can be difficult to control, they are distinct from other abnormal actions that cannot be affected by the individual's will. Evidence: TAS. Frequency: Very frequent (HP:0040281). (ORPHA:261197)
- Autistic behavior (HP:0000729): Persistent deficits in social interaction and communication and interaction as well as a markedly restricted repertoire of activity and interest as well as repetitive patterns of behavior. Evidence: TAS. Frequency: Very frequent (HP:0040281). (ORPHA:261197)
- Global developmental delay (HP:0001263): A delay in the achievement of motor or mental milestones in the domains of development of a child, including motor skills, speech and language, cognitive skills, and social and emotional skills. This term should only be used to describe children younger than five years of age. Evidence: TAS. Frequency: Very frequent (HP:0040281). (ORPHA:261197)
- Macrocephaly (HP:0000256): Occipitofrontal (head) circumference greater than 97th centile compared to appropriate, age matched, sex-matched normal standards. Alternatively, a apparently increased size of the cranium. Evidence: TAS. Frequency: Frequent (HP:0040282). (ORPHA:261197)
- Delayed speech and language development (HP:0000750): A degree of language development that is significantly below the norm for a child of a specified age. Evidence: TAS. Frequency: Frequent (HP:0040282). (ORPHA:261197)
- Intellectual disability (HP:0001249): The term intellectual disability or intellectual developmental disorder is used to describe significantly sub-average intellectual and adaptive functioning based on clinical assessment and as measured by individually administered, appropriately normed, standardized and validated tests of intellectual functioning and adaptive behavior, with onset during the developmental period from infancy through adolescence. Evidence: TAS. Frequency: Frequent (HP:0040282). (ORPHA:261197)
- Mild intellectual disability (HP:0001256): Mild intellectual disability (ID) is defined as a type of ID characterized by mildly sub-average adaptive functioning and intellectual functioning, with an intelligence quotient (IQ) the range of 50-69. Evidence: TAS. Frequency: Frequent (HP:0040282). (ORPHA:261197)
- Motor delay (HP:0001270): A type of Developmental delay characterized by a delay in acquiring motor skills. Evidence: TAS. Frequency: Frequent (HP:0040282). (ORPHA:261197)
- Specific learning disability (HP:0001328): Impairment of certain skills such as reading or writing, coordination, self-control, or attention that interfere with the ability to learn. The impairment is not related to a global deficiency of intelligence. Evidence: TAS. Frequency: Frequent (HP:0040282). (ORPHA:261197)
- Severe expressive language delay (HP:0006863): A severe delay in the acquisition of the ability to use language to communicate needs, wishes, or thoughts. Evidence: TAS. Frequency: Frequent (HP:0040282). (ORPHA:261197)
- Attention deficit hyperactivity disorder (HP:0007018): Attention deficit hyperactivity disorder (ADHD) manifests at age 2-3 years or by first grade at the latest. The main symptoms are distractibility, impulsivity, hyperactivity, and often trouble organizing tasks and projects, difficulty going to sleep, and social problems from being aggressive, loud, or impatient. Evidence: TAS. Frequency: Frequent (HP:0040282). (ORPHA:261197)
- Speech articulation difficulties (HP:0009088): Impairment in the physical production of speech sounds. Evidence: TAS. Frequency: Frequent (HP:0040282). (ORPHA:261197)
- Moderate receptive language delay (HP:0011351): A moderate delay in the acquisition of the ability to understand the speech of others. Evidence: TAS. Frequency: Frequent (HP:0040282). (ORPHA:261197)
- Brain imaging abnormality (HP:0410263): An anomaly of metabolism or structure of the brain identified by imaging. Evidence: TAS. Frequency: Frequent (HP:0040282). (ORPHA:261197)
- Hypertelorism (HP:0000316): Interpupillary distance more than 2 SD above the mean (alternatively, the appearance of an increased interpupillary distance or widely spaced eyes). Evidence: TAS. Frequency: Occasional (HP:0040283). (ORPHA:261197)
- Broad forehead (HP:0000337): Width of the forehead or distance between the frontotemporales is more than two standard deviations above the mean (objective); or apparently increased distance between the two sides of the forehead. Evidence: TAS. Frequency: Occasional (HP:0040283). (ORPHA:261197)
- Micrognathia (HP:0000347): Developmental hypoplasia of the mandible. Evidence: TAS. Frequency: Occasional (HP:0040283). (ORPHA:261197)
- Conductive hearing impairment (HP:0000405): An abnormality of vibrational conductance of sound to the inner ear leading to impairment of sensory perception of sound. Evidence: TAS. Frequency: Occasional (HP:0040283). (ORPHA:261197)
- Sensorineural hearing impairment (HP:0000407): A type of hearing impairment in one or both ears related to an abnormal functionality of the cochlear nerve. Evidence: TAS. Frequency: Occasional (HP:0040283). (ORPHA:261197)
- Autism (HP:0000717): Autism is a neurodevelopmental disorder characterized by impaired social interaction and communication, and by restricted and repetitive behavior. Autism begins in childhood. It is marked by the presence of markedly abnormal or impaired development in social interaction and communication and a markedly restricted repertoire of activity and interest. Manifestations of the disorder vary greatly depending on the developmental level and chronological age of the individual (DSM-IV). Evidence: TAS. Frequency: Occasional (HP:0040283). (ORPHA:261197)
- Motor stereotypy (HP:0000733): Use of the same abnormal action in response to certain triggers or at random. They may be used as a way to regulate one's internal state but must otherwise have no apparent functional purpose. Evidence: TAS. Frequency: Occasional (HP:0040283). (ORPHA:261197)
- Seizure (HP:0001250): A seizure is an intermittent abnormality of nervous system physiology characterized by a transient occurrence of signs and/or symptoms due to abnormal excessive or synchronous neuronal activity in the brain. Evidence: TAS. Frequency: Occasional (HP:0040283). (ORPHA:261197)
- Choreoathetosis (HP:0001266): Involuntary movements characterized by both athetosis (inability to sustain muscles in a fixed position) and chorea (widespread jerky arrhythmic movements). Evidence: TAS. Frequency: Occasional (HP:0040283). (ORPHA:261197)
- Dystonia (HP:0001332): An abnormally increased muscular tone that causes fixed abnormal postures. There is a slow, intermittent twisting motion that leads to exaggerated turning and posture of the extremities and trunk. Evidence: TAS. Frequency: Occasional (HP:0040283). (ORPHA:261197)
- Failure to thrive (HP:0001508): Failure to thrive (FTT) refers to a child whose physical growth is substantially below the norm. Evidence: TAS. Frequency: Occasional (HP:0040283). (ORPHA:261197)
- Obesity (HP:0001513): Accumulation of substantial excess body fat. Evidence: TAS. Frequency: Occasional (HP:0040283). (ORPHA:261197)
- Abnormal heart morphology (HP:0001627): Any structural anomaly of the heart. Evidence: TAS. Frequency: Occasional (HP:0040283). (ORPHA:261197)
- Atrial septal defect (HP:0001631): Atrial septal defect (ASD) is a congenital abnormality of the interatrial septum that enables blood flow between the left and right atria via the interatrial septum. Evidence: TAS. Frequency: Occasional (HP:0040283). (ORPHA:261197)
- Abnormal aortic valve morphology (HP:0001646): Any abnormality of the aortic valve. Evidence: TAS. Frequency: Occasional (HP:0040283). (ORPHA:261197)
- Abnormal facial shape (HP:0001999): An abnormal morphology (form) of the face or its components. Evidence: TAS. Frequency: Occasional (HP:0040283). (ORPHA:261197)
- Gastroesophageal reflux (HP:0002020): A condition in which the stomach contents leak backwards from the stomach into the esophagus through the lower esophageal sphincter. Evidence: TAS. Frequency: Occasional (HP:0040283). (ORPHA:261197)
- Ventriculomegaly (HP:0002119): An increase in size of the ventricular system of the brain. Evidence: TAS. Frequency: Occasional (HP:0040283). (ORPHA:261197)
- Enlarged cisterna magna (HP:0002280): Increase in size of the cisterna magna, one of three principal openings in the subarachnoid space between the arachnoid and pia mater, located between the cerebellum and the dorsal surface of the medulla oblongata. Evidence: TAS. Frequency: Occasional (HP:0040283). (ORPHA:261197)
- Scoliosis (HP:0002650): The presence of an abnormal lateral curvature of the spine. Evidence: TAS. Frequency: Occasional (HP:0040283). (ORPHA:261197)
- Platybasia (HP:0002691): A developmental malformation of the occipital bone and upper end of the cervical spine, in which the latter appears to have pushed the floor of the occipital bone upward such that there is an abnormal flattening of the skull base. Evidence: TAS. Frequency: Occasional (HP:0040283). (ORPHA:261197)
- Abnormal vertebral morphology (HP:0003468): An abnormality of one or more of the vertebrae. Evidence: TAS. Frequency: Occasional (HP:0040283). (ORPHA:261197)
- Chiari type I malformation (HP:0007099): Arnold-Chiari type I malformation refers to a relatively mild degree of herniation of the posteroinferior region of the cerebellum (the cerebellar tonsils) into the cervical canal with little or no displacement of the fourth ventricle. It is characterized by one or both pointed (not rounded) cerebellar tonsils that project 5 mm below the foramen magnum, measured by a line drawn from the basion to the opisthion (McRae Line). Evidence: TAS. Frequency: Occasional (HP:0040283). (ORPHA:261197)
- Paroxysmal dyskinesia (HP:0007166): Episodic bouts of involuntary movements with dystonic, choreic, ballistic movements, or a combination thereof. There is no loss of consciousness during the attacks. Evidence: TAS. Frequency: Occasional (HP:0040283). (ORPHA:261197)
- Speech apraxia (HP:0011098): A type of apraxia that is characterized by difficulty or inability to execute speech movements because of problems with coordination and motor problems, leading to incorrect articulation. An increase of errors with increasing word and phrase length may occur. Evidence: TAS. Frequency: Occasional (HP:0040283). (ORPHA:261197)
- Midface retrusion (HP:0011800): Posterior positions and/or vertical shortening of the infraorbital and perialar regions, or increased concavity of the face and/or reduced nasolabial angle. Evidence: TAS. Frequency: Occasional (HP:0040283). (ORPHA:261197)
- Feeding difficulties (HP:0011968): Impaired ability to eat related to problems gathering food and getting ready to suck, chew, or swallow it. Evidence: TAS. Frequency: Occasional (HP:0040283). (ORPHA:261197)
- Reduced social responsiveness (HP:0012760): A reduced ability to participate in the back-and-forth flow of social interaction appropriate to culture and developmental level, which is normally characterized by an influence of the behavior of one person on the behavior of another person. This results in difficulty interacting with others through emotional, physical, or verbal communication. Evidence: TAS. Frequency: Occasional (HP:0040283). (ORPHA:261197)
- Arachnoid cyst (HP:0100702): An extra-parenchymal and intra-arachnoidal collection of fluid with a composition similar to that of cerebrospinal fluid. Evidence: TAS. Frequency: Occasional (HP:0040283). (ORPHA:261197)
- Multicystic kidney dysplasia (HP:0000003): Multicystic dysplasia of the kidney is characterized by multiple cysts of varying size in the kidney and the absence of a normal pelvicaliceal system. The condition is associated with ureteral or ureteropelvic atresia, and the affected kidney is nonfunctional. Evidence: TAS. Frequency: Very rare (HP:0040284). (ORPHA:261197)
- Cleft palate (HP:0000175): Cleft palate is a developmental defect of the palate resulting from a failure of fusion of the palatine processes and manifesting as a separation of the roof of the mouth (soft and hard palate). Evidence: TAS. Frequency: Very rare (HP:0040284). (ORPHA:261197)
- Congenital diaphragmatic hernia (HP:0000776): The presence of a hernia of the diaphragm present at birth. Evidence: TAS. Frequency: Very rare (HP:0040284). (ORPHA:261197)
- Rib fusion (HP:0000902): Complete or partial merging of adjacent ribs. Evidence: TAS. Frequency: Very rare (HP:0040284). (ORPHA:261197)
- Hand polydactyly (HP:0001161): A kind of polydactyly characterized by the presence of a supernumerary finger or fingers. Evidence: TAS. Frequency: Very rare (HP:0040284). (ORPHA:261197)
- Craniosynostosis (HP:0001363): Craniosynostosis refers to the premature closure of the cranial sutures. Primary craniosynostosis refers to the closure of one or more sutures due to abnormalities in skull development, and secondary craniosynostosis results from failure of brain growth. Evidence: TAS. Frequency: Very rare (HP:0040284). (ORPHA:261197)
- Dextrocardia (HP:0001651): The heart is located in the right hand sided hemithorax. That is, there is a left-right reversal (or "mirror reflection") of the anatomical location of the heart in which the heart is locate on the right side instead of the left. Evidence: TAS. Frequency: Very rare (HP:0040284). (ORPHA:261197)
- Pyloric stenosis (HP:0002021): Pyloric stenosis, also known as infantile hypertrophic pyloric stenosis, is an uncommon condition in infants characterized by abnormal thickening of the pylorus muscles in the stomach leading to gastric outlet obstruction. Clinically infants are well at birth. Then, at 3 to 6 weeks of age, the infants present with projectile vomiting, potentially leading to dehydration and weight loss. Evidence: TAS. Frequency: Very rare (HP:0040284). (ORPHA:261197)
- Syringomyelia (HP:0003396): Dilated, glial-lined cavity in spinal cord. This cavity does not communicate with the central canal, and usually is between the dorsal columns unilaterally or bilaterally along the side of the cord. Evidence: TAS. Frequency: Very rare (HP:0040284). (ORPHA:261197)